- Wide mouth (HP:0000154): Distance between the oral commissures more than 2 SD above the mean. Alternatively, an apparently increased width of the oral aperture (subjective). Evidence: TAS. Frequency: Frequent (HP:0040282). (ORPHA:2429)
- Thin upper lip vermilion (HP:0000219): Height of the vermilion of the upper lip in the midline more than 2 SD below the mean. Alternatively, an apparently reduced height of the vermilion of the upper lip in the frontal view (subjective). Evidence: TAS. Frequency: Frequent (HP:0040282). (ORPHA:2429)
- Everted lower lip vermilion (HP:0000232): An abnormal configuration of the lower lip such that it is turned outward i.e., everted, with the Inner aspect of the lower lip vermilion (normally opposing the teeth) being visible in a frontal view. Evidence: TAS. Frequency: Frequent (HP:0040282). (ORPHA:2429)
- Macrocephaly (HP:0000256): Occipitofrontal (head) circumference greater than 97th centile compared to appropriate, age matched, sex-matched normal standards. Alternatively, a apparently increased size of the cranium. Evidence: TAS. Frequency: Very frequent (HP:0040281). (ORPHA:2429)
- Coarse facial features (HP:0000280): Absence of fine and sharp appearance of brows, nose, lips, mouth, and chin, usually because of rounded and heavy features or thickened skin with or without thickening of subcutaneous and bony tissues. Evidence: TAS. Frequency: Frequent (HP:0040282). (ORPHA:2429)
- Mandibular prognathia (HP:0000303): Abnormal prominence of the chin related to increased length of the mandible. Evidence: TAS. Frequency: Occasional (HP:0040283). (ORPHA:2429)
- Short philtrum (HP:0000322): Distance between nasal base and midline upper lip vermilion border more than 2 SD below the mean. Alternatively, an apparently decreased distance between nasal base and midline upper lip vermilion border. Evidence: TAS. Frequency: Frequent (HP:0040282). (ORPHA:2429)
- Prominent supraorbital ridges (HP:0000336): Greater than average forward and/or lateral protrusion of the supraorbital portion of the frontal bones. Evidence: TAS. Frequency: Frequent (HP:0040282). (ORPHA:2429)
- Broad forehead (HP:0000337): Width of the forehead or distance between the frontotemporales is more than two standard deviations above the mean (objective); or apparently increased distance between the two sides of the forehead. Evidence: TAS. Frequency: Very frequent (HP:0040281). (ORPHA:2429)
- High forehead (HP:0000348): An abnormally increased height of the forehead. Evidence: TAS. Frequency: Frequent (HP:0040282). (ORPHA:2429)
- Deeply set eye (HP:0000490): An eye that is more deeply recessed into the plane of the face than is typical. Evidence: TAS. Frequency: Frequent (HP:0040282). (ORPHA:2429)
- Thick eyebrow (HP:0000574): Increased density/number and/or increased diameter of eyebrow hairs. Evidence: TAS. Frequency: Occasional (HP:0040283). (ORPHA:2429)
- Synophrys (HP:0000664): Meeting of the medial eyebrows in the midline. Evidence: TAS. Frequency: Occasional (HP:0040283). (ORPHA:2429)
- Intellectual disability (HP:0001249): The term intellectual disability or intellectual developmental disorder is used to describe significantly sub-average intellectual and adaptive functioning based on clinical assessment and as measured by individually administered, appropriately normed, standardized and validated tests of intellectual functioning and adaptive behavior, with onset during the developmental period from infancy through adolescence. Evidence: TAS. Frequency: Very frequent (HP:0040281). (ORPHA:2429)
- Seizure (HP:0001250): A seizure is an intermittent abnormality of nervous system physiology characterized by a transient occurrence of signs and/or symptoms due to abnormal excessive or synchronous neuronal activity in the brain. Evidence: TAS. Frequency: Very frequent (HP:0040281). (ORPHA:2429)
- Spasticity (HP:0001257): A motor disorder characterized by a velocity-dependent increase in tonic stretch reflexes with increased muscle tone, exaggerated (hyperexcitable) tendon reflexes. Evidence: TAS. Frequency: Very frequent (HP:0040281). (ORPHA:2429)
- Gait disturbance (HP:0001288): The term gait disturbance can refer to any disruption of the ability to walk. Evidence: TAS. Frequency: Frequent (HP:0040282). (ORPHA:2429)
- Hyperreflexia (HP:0001347): Hyperreflexia is the presence of hyperactive stretch reflexes of the muscles. Evidence: TAS. Frequency: Frequent (HP:0040282). (ORPHA:2429)
- Truncal obesity (HP:0001956): Obesity located preferentially in the trunk of the body as opposed to the extremities. Evidence: TAS. Frequency: Frequent (HP:0040282). (ORPHA:2429)
- Low posterior hairline (HP:0002162): Hair on the neck extends more inferiorly than usual. Evidence: TAS. Frequency: Occasional (HP:0040283). (ORPHA:2429)
- Scoliosis (HP:0002650): The presence of an abnormal lateral curvature of the spine. Evidence: TAS. Frequency: Occasional (HP:0040283). (ORPHA:2429)
- Kyphosis (HP:0002808): Exaggerated anterior convexity of the thoracic vertebral column. Evidence: TAS. Frequency: Occasional (HP:0040283). (ORPHA:2429)
- Short nose (HP:0003196): Distance from nasion to subnasale more than two standard deviations below the mean, or alternatively, an apparently decreased length from the nasal root to the nasal tip. Evidence: TAS. Frequency: Occasional (HP:0040283). (ORPHA:2429)
- Thick hair (HP:0100874): Increased density of hairs, i.e., and elevated number of hairs per unit area. Evidence: TAS. Frequency: Occasional (HP:0040283). (ORPHA:2429)
These phenotypes are associated with the disease Macrocephaly-spastic paraplegia-dysmorphism syndrome (ORPHA:2429).